Phenotypes associated with the disease Macrophagic myofasciitis (ORPHA:592):
- Fever (HP:0001945): Body temperature elevated above the normal range. Evidence: TAS. Frequency: Very frequent (HP:0040281). (ORPHA:592)
- Arthralgia (HP:0002829): Joint pain. Evidence: TAS. Frequency: Very frequent (HP:0040281). (ORPHA:592)
- Generalized muscle weakness (HP:0003324): Generalized weakness or decreased strength of the muscles, affecting both distal and proximal musculature. Evidence: TAS. Frequency: Very frequent (HP:0040281). (ORPHA:592)
- Myalgia (HP:0003326): Pain in muscle. Evidence: TAS. Frequency: Very frequent (HP:0040281). (ORPHA:592)
- EMG abnormality (HP:0003457): Abnormal results of investigations using electromyography (EMG). Evidence: TAS. Frequency: Occasional (HP:0040283). (ORPHA:592)
- Fatigue (HP:0012378): A subjective feeling of tiredness characterized by a lack of energy and motivation. Evidence: TAS. Frequency: Very frequent (HP:0040281). (ORPHA:592)